Phenotypes associated with the disease Osteosclerosis-developmental delay-craniosynostosis syndrome (ORPHA:178377):
- Brachycephaly (HP:0000248): An abnormality of skull shape characterized by a decreased anterior-posterior diameter. That is, a cephalic index greater than 81%. Alternatively, an apparently shortened anteroposterior dimension (length) of the head compared to width. Evidence: TAS. Frequency: Very frequent (HP:0040281). (ORPHA:178377)
- Macrocephaly (HP:0000256): Occipitofrontal (head) circumference greater than 97th centile compared to appropriate, age matched, sex-matched normal standards. Alternatively, a apparently increased size of the cranium. Evidence: TAS. Frequency: Very frequent (HP:0040281). (ORPHA:178377)
- Hypertelorism (HP:0000316): Interpupillary distance more than 2 SD above the mean (alternatively, the appearance of an increased interpupillary distance or widely spaced eyes). Evidence: TAS. Frequency: Very frequent (HP:0040281). (ORPHA:178377)
- Broad forehead (HP:0000337): Width of the forehead or distance between the frontotemporales is more than two standard deviations above the mean (objective); or apparently increased distance between the two sides of the forehead. Evidence: TAS. Frequency: Very frequent (HP:0040281). (ORPHA:178377)
- High forehead (HP:0000348): An abnormally increased height of the forehead. Evidence: TAS. Frequency: Very frequent (HP:0040281). (ORPHA:178377)
- Hearing impairment (HP:0000365): A decreased magnitude of the sensory perception of sound. Evidence: TAS. Frequency: Occasional (HP:0040283). (ORPHA:178377)
- Visual impairment (HP:0000505): Visual impairment (or vision impairment) is vision loss (of a person) to such a degree as to qualify as an additional support need through a significant limitation of visual capability resulting from either disease, trauma, or congenital or degenerative conditions that cannot be corrected by conventional means, such as refractive correction, medication, or surgery. Evidence: TAS. Frequency: Occasional (HP:0040283). (ORPHA:178377)
- Optic atrophy (HP:0000648): Atrophy of the optic nerve. Optic atrophy results from the death of the retinal ganglion cell axons that comprise the optic nerve and manifesting as a pale optic nerve on fundoscopy. Evidence: TAS. Frequency: Occasional (HP:0040283). (ORPHA:178377)
- Craniosynostosis (HP:0001363): Craniosynostosis refers to the premature closure of the cranial sutures. Primary craniosynostosis refers to the closure of one or more sutures due to abnormalities in skull development, and secondary craniosynostosis results from failure of brain growth. Evidence: TAS. Frequency: Frequent (HP:0040282). (ORPHA:178377)
- Headache (HP:0002315): Cephalgia, or pain sensed in various parts of the head, not confined to the area of distribution of any nerve. Evidence: TAS. Frequency: Occasional (HP:0040283). (ORPHA:178377)
- Increased intracranial pressure (HP:0002516): An increase of the pressure inside the cranium (skull) and thereby in the brain tissue and cerebrospinal fluid. Evidence: TAS. Frequency: Occasional (HP:0040283). (ORPHA:178377)
- Thickened calvaria (HP:0002684): The presence of an abnormally thick calvaria. Evidence: TAS. Frequency: Very frequent (HP:0040281). (ORPHA:178377)
- Facial palsy (HP:0010628): Facial nerve palsy is a dysfunction of cranial nerve VII (the facial nerve) that results in inability to control facial muscles on the affected side with weakness of the muscles of facial expression and eye closure. This can either be present in unilateral or bilateral form. Evidence: TAS. Frequency: Occasional (HP:0040283). (ORPHA:178377)
- Increased bone mineral density (HP:0011001): An abnormal increase of bone mineral density, that is, of the amount of matter per cubic centimeter of bones which is often referred to as osteosclerosis. Osteosclerosis can be detected on radiological examination as an increased whiteness (density) of affected bones. Evidence: TAS. Frequency: Very frequent (HP:0040281). (ORPHA:178377)
- Mild global developmental delay (HP:0011342): A mild delay in the achievement of motor or mental milestones in the domains of development of a child. Evidence: TAS. Frequency: Occasional (HP:0040283). (ORPHA:178377)
- Broad jaw (HP:0012802): Bigonial distance (lower facial width) more than 2 SD above the mean (objective); or an apparently increased width of the lower jaw (mandible) when viewed from the front (subjective). Evidence: TAS. Frequency: Very frequent (HP:0040281). (ORPHA:178377)